Phenotypes associated with the disease Trichothiodystrophy (ORPHA:33364):
- Global developmental delay (HP:0001263): A delay in the achievement of motor or mental milestones in the domains of development of a child, including motor skills, speech and language, cognitive skills, and social and emotional skills. This term should only be used to describe children younger than five years of age. Evidence: TAS. Frequency: Occasional (HP:0040283). (ORPHA:33364)
- Cryptorchidism (HP:0000028): Testis in inguinal canal. That is, absence of one or both testes from the scrotum owing to failure of the testis or testes to descend through the inguinal canal to the scrotum. Evidence: TAS. Frequency: Occasional (HP:0040283). (ORPHA:33364)
- Gonadal dysgenesis (HP:0000133): Gonadal dysgenesis is the name given to any of a multitude of conditions that can cause impaired development of the gonads, i.e., the testes or ovaries, or to the related phenotypic features. The term is to be avoided if possible for new annotations, and more specific terms should be chosen. Evidence: TAS. Frequency: Occasional (HP:0040283). (ORPHA:33364)
- Microcephaly (HP:0000252): Head circumference below 2 standard deviations below the mean for age and gender. Evidence: TAS. Frequency: Occasional (HP:0040283). (ORPHA:33364)
- Retrognathia (HP:0000278): An abnormality in which the mandible is mislocalised posteriorly. Evidence: TAS. Frequency: Occasional (HP:0040283). (ORPHA:33364)
- Coarse facial features (HP:0000280): Absence of fine and sharp appearance of brows, nose, lips, mouth, and chin, usually because of rounded and heavy features or thickened skin with or without thickening of subcutaneous and bony tissues. Evidence: TAS. Frequency: Occasional (HP:0040283). (ORPHA:33364)
- Epicanthus (HP:0000286): A fold of skin starting above the medial aspect of the upper eyelid and arching downward to cover, pass in front of and lateral to the medial canthus. Evidence: TAS. Frequency: Occasional (HP:0040283). (ORPHA:33364)
- Hypertelorism (HP:0000316): Interpupillary distance more than 2 SD above the mean (alternatively, the appearance of an increased interpupillary distance or widely spaced eyes). Evidence: TAS. Frequency: Occasional (HP:0040283). (ORPHA:33364)
- Bird-like facies (HP:0000320). Evidence: TAS. Frequency: Occasional (HP:0040283). (ORPHA:33364)
- Protruding ear (HP:0000411): Angle formed by the plane of the ear and the mastoid bone greater than the 97th centile for age (objective); or, outer edge of the helix more than 2 cm from the mastoid at the point of maximum distance (objective). Evidence: TAS. Frequency: Occasional (HP:0040283). (ORPHA:33364)
- Microcornea (HP:0000482): A congenital abnormality of the cornea in which the cornea and the anterior segment of the eye are smaller than normal. The horizontal diameter of the cornea does not reach 10 mm even in adulthood. Evidence: TAS. Frequency: Occasional (HP:0040283). (ORPHA:33364)
- Astigmatism (HP:0000483): A type of refraction error associated with abnormal curvatures on the anterior and/or posterior surface of the cornea. Evidence: TAS. Frequency: Occasional (HP:0040283). (ORPHA:33364)
- Strabismus (HP:0000486): A misalignment of the eyes so that the visual axes deviate from bifoveal fixation. The classification of strabismus may be based on a number of features including the relative position of the eyes, whether the deviation is latent or manifest, intermittent or constant, concomitant or otherwise and according to the age of onset and the relevance of any associated refractive error. Evidence: TAS. Frequency: Occasional (HP:0040283). (ORPHA:33364)
- Conjunctivitis (HP:0000509): Inflammation of the conjunctiva. Evidence: TAS. Frequency: Occasional (HP:0040283). (ORPHA:33364)
- Developmental cataract (HP:0000519): A cataract that occurs congenitally as the result of a developmental defect, in contrast to the majority of cataracts that occur in adulthood as the result of degenerative changes of the lens. Evidence: TAS. Frequency: Occasional (HP:0040283). (ORPHA:33364)
- Myopia (HP:0000545): An abnormality of refraction characterized by the ability to see objects nearby clearly, while objects in the distance appear blurry. Evidence: TAS. Frequency: Occasional (HP:0040283). (ORPHA:33364)
- Retinal degeneration (HP:0000546): A nonspecific term denoting progressive loss of the retinal pigment epithelium (RPE) and/or neurosensory retinal cells. Evidence: TAS. Frequency: Occasional (HP:0040283). (ORPHA:33364)
- Esotropia (HP:0000565): A form of strabismus with one or both eyes turned inward ('crossed') to a relatively severe degree, usually defined as 10 diopters or more. Evidence: TAS. Frequency: Occasional (HP:0040283). (ORPHA:33364)
- Hypotelorism (HP:0000601): Interpupillary distance less than 2 SD below the mean (alternatively, the appearance of an decreased interpupillary distance or closely spaced eyes). Evidence: TAS. Frequency: Occasional (HP:0040283). (ORPHA:33364)
- Macular degeneration (HP:0000608): A nonspecific term denoting degeneration of the retinal pigment epithelium and/or retinal photoreceptor cells of the macula lutea. Evidence: TAS. Frequency: Occasional (HP:0040283). (ORPHA:33364)
- Photophobia (HP:0000613): Excessive sensitivity to light with the sensation of discomfort or pain in the eyes due to exposure to bright light. Evidence: TAS. Frequency: Occasional (HP:0040283). (ORPHA:33364)
- Nystagmus (HP:0000639): Rhythmic, involuntary oscillations of one or both eyes related to abnormality in fixation, conjugate gaze, or vestibular mechanisms. Evidence: TAS. Frequency: Occasional (HP:0040283). (ORPHA:33364)
- Ectropion (HP:0000656): An outward turning (eversion) or rotation of the eyelid margin. Evidence: TAS. Frequency: Occasional (HP:0040283). (ORPHA:33364)
- Carious teeth (HP:0000670): Caries is a multifactorial bacterial infection affecting the structure of the tooth. This term has been used to describe the presence of more than expected dental caries. Evidence: TAS. Frequency: Occasional (HP:0040283). (ORPHA:33364)
- Osteopenia (HP:0000938): Osteopenia is a term to define bone density that is not normal but also not as low as osteoporosis. By definition from the World Health Organization osteopenia is defined by bone densitometry as a T score -1 to -2.5. Evidence: TAS. Frequency: Occasional (HP:0040283). (ORPHA:33364)
- Dry skin (HP:0000958): Skin characterized by the lack of natural or normal moisture. Evidence: TAS. Frequency: Occasional (HP:0040283). (ORPHA:33364)
- Eczematoid dermatitis (HP:0000964): Eczema is a form of dermatitis that is characterized by scaly, pruritic, erythematous lesions located on flexural surfaces. Evidence: TAS. Frequency: Occasional (HP:0040283). (ORPHA:33364)
- Cutaneous photosensitivity (HP:0000992): An increased sensitivity of the skin to light. Photosensitivity may result in a rash upon exposure to the sun (which is known as photodermatosis). Photosensitivity can be diagnosed by phototests in which light is shone on small areas of skin. Evidence: TAS. Frequency: Occasional (HP:0040283). (ORPHA:33364)
- Keratoconjunctivitis sicca (HP:0001097): Dryness of the eye related to deficiency of the tear film components (aqueous, mucin, or lipid), lid surface abnormalities, or epithelial abnormalities. Keratoconjunctivitis sicca often results in a scratchy or sandy sensation (foreign body sensation) in the eyes, and may also be associated with itching, inability to produce tears, photosensitivity, redness, pain, and difficulty in moving the eyelids. Evidence: TAS. Frequency: Occasional (HP:0040283). (ORPHA:33364)
- Abnormality of prenatal development or birth (HP:0001197): An abnormality of the fetus or the birth of the fetus, excluding structural abnormalities. Evidence: TAS. Frequency: Occasional (HP:0040283). (ORPHA:33364)
- Clubbing (HP:0001217): Broadening of the soft tissues (non-edematous swelling of soft tissues) of the digital tips in all dimensions associated with an increased longitudinal and lateral curvature of the nails. Evidence: TAS. Frequency: Occasional (HP:0040283). (ORPHA:33364)
- Spasticity (HP:0001257): A motor disorder characterized by a velocity-dependent increase in tonic stretch reflexes with increased muscle tone, exaggerated (hyperexcitable) tendon reflexes. Evidence: TAS. Frequency: Occasional (HP:0040283). (ORPHA:33364)
- Dysarthria (HP:0001260): Dysarthric speech is a general description referring to a neurological speech disorder characterized by poor articulation. Depending on the involved neurological structures, dysarthria may be further classified as spastic, flaccid, ataxic, hyperkinetic and hypokinetic, or mixed. Evidence: TAS. Frequency: Occasional (HP:0040283). (ORPHA:33364)
- Hyporeflexia (HP:0001265): Reduction of neurologic reflexes such as the knee-jerk reaction. Evidence: TAS. Frequency: Occasional (HP:0040283). (ORPHA:33364)
- Hypertonia (HP:0001276): A condition in which there is increased muscle tone so that arms or legs, for example, are stiff and difficult to move. Evidence: TAS. Frequency: Occasional (HP:0040283). (ORPHA:33364)
- Generalized hypotonia (HP:0001290): Generalized muscular hypotonia (abnormally low muscle tone). Evidence: TAS. Frequency: Occasional (HP:0040283). (ORPHA:33364)
- Partial agenesis of the corpus callosum (HP:0001338): A partial failure of the development of the corpus callosum. Evidence: TAS. Frequency: Occasional (HP:0040283). (ORPHA:33364)
- Craniosynostosis (HP:0001363): Craniosynostosis refers to the premature closure of the cranial sutures. Primary craniosynostosis refers to the closure of one or more sutures due to abnormalities in skull development, and secondary craniosynostosis results from failure of brain growth. Evidence: TAS. Frequency: Occasional (HP:0040283). (ORPHA:33364)
- Joint dislocation (HP:0001373): Displacement or malalignment of joints. Evidence: TAS. Frequency: Occasional (HP:0040283). (ORPHA:33364)
- Intrauterine growth retardation (HP:0001511): An abnormal restriction of fetal growth with fetal weight below the tenth percentile for gestational age. Evidence: TAS. Frequency: Occasional (HP:0040283). (ORPHA:33364)
- Umbilical hernia (HP:0001537): Protrusion of abdominal contents through a defect in the abdominal wall musculature around the umbilicus. Skin and subcutaneous tissue overlie the defect. Evidence: TAS. Frequency: Occasional (HP:0040283). (ORPHA:33364)
- Concave nail (HP:0001598): The natural longitudinal (posterodistal) convex arch is not present or is inverted. Evidence: TAS. Frequency: Occasional (HP:0040283). (ORPHA:33364)
- Dysphonia (HP:0001618): Difficulty in speaking due to a physical disorder of the mouth, tongue, throat, or vocal cords. Associated with a known physical or neurological cause. Evidence: TAS. Frequency: Occasional (HP:0040283). (ORPHA:33364)
- Ventricular septal defect (HP:0001629): A hole between the two bottom chambers (ventricles) of the heart. The defect is centered around the most superior aspect of the ventricular septum. Evidence: TAS. Frequency: Occasional (HP:0040283). (ORPHA:33364)
- Cardiomyopathy (HP:0001638): A myocardial disorder in which the heart muscle is structurally and functionally abnormal, in the absence of coronary artery disease, hypertension, valvular disease and congenital heart disease sufficient to cause the observed myocardial abnormality. Evidence: TAS. Frequency: Occasional (HP:0040283). (ORPHA:33364)
- Ridged nail (HP:0001807): Longitudinal, linear prominences in the nail plate. Evidence: TAS. Frequency: Occasional (HP:0040283). (ORPHA:33364)
- Fragile nails (HP:0001808): Nails that easily break. Evidence: TAS. Frequency: Occasional (HP:0040283). (ORPHA:33364)
- Split nail (HP:0001809): A nail plate that has a longitudinal separation and the two sections of the nail share the same lateral radius of curvature. Evidence: TAS. Frequency: Occasional (HP:0040283). (ORPHA:33364)
- Decreased total neutrophil count (HP:0001875): Abnormal decrease of absolute number of neutrophils in the blood, per microlitre, compared to a reference range for a given sex and age-group. Evidence: TAS. Frequency: Occasional (HP:0040283). (ORPHA:33364)
- Anemia (HP:0001903): A reduction in erythrocytes volume or hemoglobin concentration. Evidence: TAS. Frequency: Occasional (HP:0040283). (ORPHA:33364)
- Gait ataxia (HP:0002066): A type of ataxia characterized by the impairment of the ability to coordinate the movements required for normal walking. Gait ataxia is characteirzed by a wide-based staggering gait with a tendency to fall. Evidence: TAS. Frequency: Occasional (HP:0040283). (ORPHA:33364)
- Intention tremor (HP:0002080): A type of kinetic tremor that occurs during target directed movement is called intention tremor. That is, an oscillatory cerebellar ataxia that tends to be absent when the limbs are inactive and during the first part of voluntary movement but worsening as the movement continues and greater precision is required (e.g., in touching a target such as the patient's nose or a physician's finger). Evidence: TAS. Frequency: Occasional (HP:0040283). (ORPHA:33364)
- Ventriculomegaly (HP:0002119): An increase in size of the ventricular system of the brain. Evidence: TAS. Frequency: Occasional (HP:0040283). (ORPHA:33364)
- Cerebral cortical atrophy (HP:0002120): Atrophy of the cortex of the cerebrum. Evidence: TAS. Frequency: Occasional (HP:0040283). (ORPHA:33364)
- Generalized-onset seizure (HP:0002197): A generalized-onset seizure is a type of seizure originating at some point within, and rapidly engaging, bilaterally distributed networks. The networks may include cortical and subcortical structures but not necessarily the entire cortex. Evidence: TAS. Frequency: Occasional (HP:0040283). (ORPHA:33364)
- Sparse scalp hair (HP:0002209): Decreased number of hairs per unit area of skin of the scalp. Evidence: TAS. Frequency: Occasional (HP:0040283). (ORPHA:33364)
- Alopecia of scalp (HP:0002293). Evidence: TAS. Frequency: Occasional (HP:0040283). (ORPHA:33364)
- Brittle hair (HP:0002299): Fragile, easily breakable hair, i.e., with reduced tensile strength. Evidence: TAS. Frequency: Occasional (HP:0040283). (ORPHA:33364)
- Low-set nipples (HP:0002562): Placement of the nipples at a lower than normal location. Evidence: TAS. Frequency: Occasional (HP:0040283). (ORPHA:33364)
- High, narrow palate (HP:0002705): The presence of a high and narrow palate. Evidence: TAS. Frequency: Occasional (HP:0040283). (ORPHA:33364)
- Recurrent infections (HP:0002719): Increased susceptibility to infections as manifested by repeated bouts of infection. Evidence: TAS. Frequency: Occasional (HP:0040283). (ORPHA:33364)
- Delayed skeletal maturation (HP:0002750): A decreased rate of skeletal maturation. Delayed skeletal maturation can be diagnosed on the basis of an estimation of the bone age from radiographs of specific bones in the human body. Evidence: TAS. Frequency: Occasional (HP:0040283). (ORPHA:33364)
- Multiple joint contractures (HP:0002828). Evidence: TAS. Frequency: Occasional (HP:0040283). (ORPHA:33364)
- Squamous cell carcinoma (HP:0002860): The presence of squamous cell carcinoma of the skin. Evidence: TAS. Frequency: Occasional (HP:0040283). (ORPHA:33364)
- Thoracic kyphosis (HP:0002942): Over curvature of the thoracic region, leading to a round back or if sever to a hump. Evidence: TAS. Frequency: Occasional (HP:0040283). (ORPHA:33364)
- Defective DNA repair after ultraviolet radiation damage (HP:0003079). Evidence: TAS. Frequency: Occasional (HP:0040283). (ORPHA:33364)
- Panhypogammaglobulinemia (HP:0003139): A reduction in the circulating levels of all the major classes of immunoglobulin. is characterized by profound decreases in all classes of immunoglobulin with an absence of circulating B lymphocytes. Evidence: TAS. Frequency: Occasional (HP:0040283). (ORPHA:33364)
- Enamel hypoplasia (HP:0006297): Developmental hypoplasia of the dental enamel. Evidence: TAS. Frequency: Occasional (HP:0040283). (ORPHA:33364)
- Recurrent bronchopulmonary infections (HP:0006538): An increased susceptibility to bronchopulmonary infections as manifested by a history of recurrent bronchopulmonary infections. Evidence: TAS. Frequency: Occasional (HP:0040283). (ORPHA:33364)
- Periventricular leukomalacia (HP:0006970): Periventricular leukomalacia is characterized by diffuse injury of deep cerebral white matter, accompanied in its most severe form by focal necrosis. The neuropathologic hallmarks of PVL are microglial activation and focal and diffuse periventricular depletion of premyelinating oligodendroglia. Evidence: TAS. Frequency: Occasional (HP:0040283). (ORPHA:33364)
- Generalized hyperreflexia (HP:0007034). Evidence: TAS. Frequency: Occasional (HP:0040283). (ORPHA:33364)
- Abnormal pyramidal sign (HP:0007256): Functional neurological abnormalities related to dysfunction of the pyramidal tract. Evidence: TAS. Frequency: Occasional (HP:0040283). (ORPHA:33364)
- Cerebral dysmyelination (HP:0007266): Defective structure and function of myelin sheaths of the white matter of the brain. Evidence: TAS. Frequency: Occasional (HP:0040283). (ORPHA:33364)
- Congenital exfoliative erythroderma (HP:0007381). Evidence: TAS. Frequency: Occasional (HP:0040283). (ORPHA:33364)
- Absence of subcutaneous fat (HP:0007485): Lack of subcutaneous adipose tissue. Evidence: TAS. Frequency: Occasional (HP:0040283). (ORPHA:33364)
- Prematurely aged appearance (HP:0007495). Evidence: TAS. Frequency: Occasional (HP:0040283). (ORPHA:33364)
- Numerous pigmented freckles (HP:0007587). Evidence: TAS. Frequency: Occasional (HP:0040283). (ORPHA:33364)
- Bilateral microphthalmos (HP:0007633): A developmental anomaly characterized by abnormal smallness of both eyes. Evidence: TAS. Frequency: Occasional (HP:0040283). (ORPHA:33364)
- Ichthyosis (HP:0008064): An abnormality of the skin characterized the presence of excessive amounts of dry surface scales on the skin resulting from an abnormality of keratinization. Evidence: TAS. Frequency: Occasional (HP:0040283). (ORPHA:33364)
- Aplasia/Hypoplasia of the nails (HP:0008386): Aplasia or developmental hypoplasia of the nail. Evidence: TAS. Frequency: Occasional (HP:0040283). (ORPHA:33364)
- Dystrophic fingernails (HP:0008391): The presence of misshapen or partially destroyed nail plates, often with accumulation of soft, yellow keratin between the dystrophic nail plate and nail bed, resulting in elevation of the nail plate. Evidence: TAS. Frequency: Occasional (HP:0040283). (ORPHA:33364)
- Bilateral sensorineural hearing impairment (HP:0008619): A form of sensorineural hearing impairment that affects both ears. Evidence: TAS. Frequency: Occasional (HP:0040283). (ORPHA:33364)
- Peripheral neuropathy (HP:0009830): Peripheral neuropathy is a general term for any disorder of the peripheral nervous system. The main clinical features used to classify peripheral neuropathy are distribution, type (mainly demyelinating versus mainly axonal), duration, and course. Evidence: TAS. Frequency: Occasional (HP:0040283). (ORPHA:33364)
- Paraplegia/paraparesis (HP:0010551): Weakness of both lower extremities with sparing of the upper extremities. Paraplegia refers to a severe or complete loss of strength, whereas paraparesis refers to a relatively mild loss of strength. Evidence: TAS. Frequency: Occasional (HP:0040283). (ORPHA:33364)
- Increased bone mineral density (HP:0011001): An abnormal increase of bone mineral density, that is, of the amount of matter per cubic centimeter of bones which is often referred to as osteosclerosis. Osteosclerosis can be detected on radiological examination as an increased whiteness (density) of affected bones. Evidence: TAS. Frequency: Occasional (HP:0040283). (ORPHA:33364)
- Reduced social responsiveness (HP:0012760): A reduced ability to participate in the back-and-forth flow of social interaction appropriate to culture and developmental level, which is normally characterized by an influence of the behavior of one person on the behavior of another person. This results in difficulty interacting with others through emotional, physical, or verbal communication. Evidence: TAS. Frequency: Occasional (HP:0040283). (ORPHA:33364)
- Increased mean corpuscular hemoglobin concentration (HP:0025548): An elevation over the normal range of the average amount of hemoglobin per red blood cell (27 to 31 picograms/cell). Evidence: TAS. Frequency: Occasional (HP:0040283). (ORPHA:33364)
- Tiger tail banding (HP:0045055): An abnormal appearance of hair under polarizing microscopy (using crossed polarizers), whereby hair shafts show striking alternating bright and dark bands, often referred to as tiger tail banding. Evidence: TAS. Frequency: Occasional (HP:0040283). (ORPHA:33364)
- Diffuse cerebellar atrophy (HP:0100275): Diffuse unlocalised atrophy affecting the cerebellum. Evidence: TAS. Frequency: Occasional (HP:0040283). (ORPHA:33364)
- Hypoplasia of mandible relative to maxilla (HP:0410219): Abnormally small dimension of the mandible (lower jaw) relative to the maxilla (upper jaw). Evidence: TAS. Frequency: Occasional (HP:0040283). (ORPHA:33364)
- Bronchoconstriction (HP:4000007): Tightening of smooth muscle surrounding the bronchi and bronchioles with consequent wheezing and shortness of breath. Evidence: TAS. Frequency: Occasional (HP:0040283). (ORPHA:33364)